Phenotypes associated with the disease presenile dementia, Kraepelin type (OMIM:176600):
- Dementia (HP:0000726): A loss of global cognitive ability of sufficient amount to interfere with normal social or occupational function. Dementia represents a loss of previously present cognitive abilities, generally in adults, and can affect memory, thinking, language, judgment, and behavior. Evidence: TAS. (OMIM:176600)
- Autosomal dominant inheritance (HP:0000006): A mode of inheritance that is observed for traits related to a gene encoded on one of the autosomes (i.e., the human chromosomes 1-22) in which a trait manifests in heterozygotes. In the context of medical genetics, an autosomal dominant disorder is caused when a single copy of the mutant allele is present. Males and females are affected equally, and can both transmit the disorder with a risk of 50% for each child of inheriting the mutant allele. Evidence: IEA. (OMIM:176600)